Phenotypes associated with the disease Emery-Dreifuss muscular dystrophy 5, autosomal dominant (OMIM:612999):
- Centrally nucleated skeletal muscle fibers (HP:0003687): An abnormality in which the nuclei of sarcomeres take on an abnormally central localization (or in which this feature is found in an increased proportion of muscle cells). Evidence: PCS. Frequency: 1/1. (PMID:17761684)
- Elevated circulating creatine kinase activity (HP:0003236): The activity of creatine kinase in the blood circulation is above the upper limit of normal. Evidence: PCS. Frequency: 1/1. (PMID:17761684)
- Juvenile onset (HP:0003621): Onset of signs or symptoms of disease between the age of 5 and 15 years. Evidence: PCS. Frequency: 1/1. (PMID:17761684)
- Myopathy (HP:0003198): A disorder of muscle unrelated to impairment of innervation or neuromuscular junction. Evidence: PCS. Frequency: 1/1. (PMID:17761684)
- Scapular winging (HP:0003691): Abnormal protrusion of the scapula away from the surface of the back. Evidence: PCS. Frequency: 1/1. (PMID:17761684)
- Muscular dystrophy (HP:0003560): The term dystrophy means abnormal growth. However, muscular dystrophy is used to describe primary myopathies with a genetic basis and a progressive course characterized by progressive skeletal muscle weakness and wasting, defects in muscle proteins, and histological features of muscle fiber degeneration (necrosis) and regeneration. If possible, it is preferred to use other HPO terms to describe the precise phenotypic abnormalities. Evidence: TAS. (OMIM:612999)
- Arrhythmia (HP:0011675): Any cardiac rhythm other than the normal sinus rhythm. Such a rhythm may be either of sinus or ectopic origin and either regular or irregular. An arrhythmia may be due to a disturbance in impulse formation or conduction or both. Evidence: TAS. (OMIM:612999)
- Respiratory insufficiency (HP:0002093). Evidence: PCS. Frequency: 1/1. (PMID:17761684)
- Childhood onset (HP:0011463): Onset of disease at the age of between 1 and 5 years. Evidence: TAS. (OMIM:612999)
- Cardiomyopathy (HP:0001638): A myocardial disorder in which the heart muscle is structurally and functionally abnormal, in the absence of coronary artery disease, hypertension, valvular disease and congenital heart disease sufficient to cause the observed myocardial abnormality. Evidence: TAS. (OMIM:612999)
- Proximal amyotrophy (HP:0007126): Amyotrophy (muscular atrophy) affecting the proximal musculature. Evidence: TAS. (OMIM:612999)
- Proximal muscle weakness (HP:0003701): A lack of strength of the proximal muscles. Evidence: TAS. (OMIM:612999)
- Autosomal dominant inheritance (HP:0000006): A mode of inheritance that is observed for traits related to a gene encoded on one of the autosomes (i.e., the human chromosomes 1-22) in which a trait manifests in heterozygotes. In the context of medical genetics, an autosomal dominant disorder is caused when a single copy of the mutant allele is present. Males and females are affected equally, and can both transmit the disorder with a risk of 50% for each child of inheriting the mutant allele. Evidence: PCS. (PMID:17761684)
- Increased variability in muscle fiber diameter (HP:0003557): An abnormally high degree of muscle fiber size variation. This phenotypic feature can be observed upon muscle biopsy. Evidence: PCS. Frequency: 1/1. (PMID:17761684)